- Arthrogryposis-like hand anomaly (HP:0005612). Evidence: IEA. (OMIM:108200)
- Sensorineural hearing impairment (HP:0000407): A type of hearing impairment in one or both ears related to an abnormal functionality of the cochlear nerve. Evidence: IEA. (OMIM:108200)
- Arthrogryposis multiplex congenita (HP:0002804): Multiple congenital contractures in different body areas. Evidence: IEA. (OMIM:108200)
- Autosomal dominant inheritance (HP:0000006): A mode of inheritance that is observed for traits related to a gene encoded on one of the autosomes (i.e., the human chromosomes 1-22) in which a trait manifests in heterozygotes. In the context of medical genetics, an autosomal dominant disorder is caused when a single copy of the mutant allele is present. Males and females are affected equally, and can both transmit the disorder with a risk of 50% for each child of inheriting the mutant allele. Evidence: IEA. (OMIM:108200)
These phenotypes are associated with the disease arthrogryposis-like hand anomaly-sensorineural deafness syndrome (OMIM:108200).